Phenotypes associated with the disease multiple mitochondrial dysfunctions syndrome 7 (OMIM:620423):
- Lethargy (HP:0001254): A state of fatigue, either physical or mental slowness and sluggishness, with difficulties in initiating or performing simple tasks. Distinguished from apathy which implies indifference and a lack of desire or interest in the task. A person with lethargy may have the desire, but not the energy to engage in personal or socially relevant tasks. Evidence: PCS. Frequency: 5/5. (PMID:33890291;PMID:36190515)
- Exaggerated startle response (HP:0002267): An exaggerated startle reaction in response to a sudden unexpected visual or acoustic stimulus, or a quick movement near the face. Evidence: PCS. Frequency: 1/1. (PMID:36190515)
- Decreased liver function (HP:0001410): Reduced ability of the liver to perform its functions. Evidence: PCS. Frequency: 1/1. (PMID:36190515)
- Dystonia (HP:0001332): An abnormally increased muscular tone that causes fixed abnormal postures. There is a slow, intermittent twisting motion that leads to exaggerated turning and posture of the extremities and trunk. Evidence: PCS. Frequency: 1/1. (PMID:36190515)
- Seizure (HP:0001250): A seizure is an intermittent abnormality of nervous system physiology characterized by a transient occurrence of signs and/or symptoms due to abnormal excessive or synchronous neuronal activity in the brain. Evidence: PCS. Frequency: 4/4. (PMID:33890291;PMID:36190515)
- Hypotonia (HP:0001252): Hypotonia is an abnormally low muscle tone (the amount of tension or resistance to movement in a muscle). Even when relaxed, muscles have a continuous and passive partial contraction which provides some resistance to passive stretching. Hypotonia thus manifests as diminished resistance to passive stretching. Hypotonia is not the same as muscle weakness, although the two conditions can co-exist. Evidence: PCS. Frequency: 4/5. (PMID:33890291;PMID:36190515)
- Elevated brain lactate level by MRS (HP:0012707): An increase in the level of lactate in the brain identified by magnetic resonance spectroscopy (MRS). Evidence: PCS. Frequency: 2/2. (PMID:33890291)
- Reduced brain N-acetyl aspartate level by MRS (HP:0012708): A decrease in the level of N-acetyl aspartate in the brain identified by magnetic resonance spectroscopy (MRS). Evidence: PCS. Frequency: 1/1. (PMID:36190515)
- Infantile onset (HP:0003593): Onset of signs or symptoms of disease between 28 days to one year of life. Evidence: PCS. Frequency: 4/9. (PMID:33890291;PMID:36190515)
- Myoclonic seizure (HP:0032794): A myoclonic seizure is a type of motor seizure characterized by sudden, brief (<100 ms) involuntary single or multiple contraction of muscles or muscle groups of variable topography (axial, proximal limb, distal). Myoclonus is less regularly repetitive and less sustained than is clonus. Evidence: PCS. Frequency: 1/1. (PMID:33890291)
- Hyperglycemia (HP:0003074): An increased concentration of glucose in the blood. Evidence: PCS. Frequency: 5/5. (PMID:36190515)
- Partial atrioventricular canal defect (HP:0011577): A specific combination of heart defects including a primum atrial septal defect and cleft anterior mitral valve leaflet. There is not an inlet ventricular septal defect present. There are two valve annuluses and two valve orifices. Evidence: PCS. Frequency: 1/1. (PMID:33890291)
- Thin corpus callosum (HP:0033725): An abnormally thin corpus callous, due to atrophy, hypoplasia or agenesis. This term is intended to be used in situations where it is not known if thinning of the corpus callosum (for instance, as visualized by magnetic resonance tomography) is due to abnormal development (e.g. a leukodystrophy) or atrophy following normal development (e.g. neurodegeneration). Evidence: PCS. Frequency: 1/1. (PMID:36190515)
- Infantile spasms (HP:0012469): Infantile spasms represent a subset of "epileptic spasms". Infantile Spasms are epileptic spasms starting in the first year of life (infancy). Evidence: PCS. Frequency: 2/2. (PMID:36190515)
- Recurrent singultus (HP:0100247): A contraction of the diaphragm that repeats several times per minute. In humans, the abrupt rush of air into the lungs causes the epiglottis to close, creating a hic sound. Also known as synchronous diaphragmatic flutter (SDF), or singultus, from the Latin singult, the act of catching one's breath while sobbing. The hiccup is an involuntary action involving a reflex arc. Evidence: PCS. Frequency: 1/1. (PMID:36190515)
- Agitation (HP:0000713): A state of excessive motor activity that is associated with mental distress or a feeling of substantial unease or inner tension. Distinguished from restlessness by the increased level of emotional distress and negative intensity of the experience. Agitation has a significant level of physical activity that is typically threatening to the self or others. Evidence: PCS. Frequency: 1/1. (PMID:36190515)
- Hyperactivity (HP:0000752): Hyperactivity is a condition characterized by constant and unusually high levels of activity, even in situations where it is deemed inappropriate. Evidence: PCS. Frequency: 3/3. (PMID:36190515)
- Hypernatremia (HP:0003228): The concentration of sodium in the blood circulation is above the upper limit of normal. Evidence: PCS. Frequency: 1/2. (PMID:33890291)
- Neonatal onset (HP:0003623): Onset of signs or symptoms of disease within the first 28 days of life. Evidence: PCS. Frequency: 3/9. (PMID:33890291;PMID:36190515)
- Hypoplasia of the corpus callosum (HP:0002079): Underdevelopment of the corpus callosum. Evidence: PCS. Frequency: 2/2. (PMID:36190515)
- Feeding difficulties (HP:0011968): Impaired ability to eat related to problems gathering food and getting ready to suck, chew, or swallow it. Evidence: PCS. Frequency: 3/3. (PMID:33890291;PMID:36190515)
- Poor suck (HP:0002033): An inadequate sucking reflex, resulting in the difficult of newborns to be breast-fed. Evidence: PCS. Frequency: 1/1. (PMID:33890291)
- Hyperglycinemia (HP:0002154): An elevated concentration of glycine in the blood. Evidence: PCS. Frequency: 1/1. (PMID:33890291)
- Global developmental delay (HP:0001263): A delay in the achievement of motor or mental milestones in the domains of development of a child, including motor skills, speech and language, cognitive skills, and social and emotional skills. This term should only be used to describe children younger than five years of age. Evidence: PCS. Frequency: 6/6. (PMID:33890291;PMID:36190515)
- Ankle clonus (HP:0011448): Clonus is an involuntary tendon reflex that causes repeated flexion and extension of the foot. Ankle clonus is tested by rapidly flexing the foot upward. Evidence: PCS. Frequency: 1/1. (PMID:33890291)
- Increased CSF glycine concentration (HP:0500230): Abnormally increased levels of glycine in cerebrospinal fluid. Evidence: PCS. Frequency: 6/6. (PMID:33890291;PMID:36190515)
- Autistic behavior (HP:0000729): Persistent deficits in social interaction and communication and interaction as well as a markedly restricted repertoire of activity and interest as well as repetitive patterns of behavior. Evidence: PCS. Frequency: 1/1. (PMID:36190515)
- Multifocal seizures (HP:0031165): Seizures that start from several different areas of the brain (i.e., with multiple ictal onset locations). Evidence: PCS. Frequency: 1/1. (PMID:36190515)
- Autosomal recessive inheritance (HP:0000007): A mode of inheritance that is observed for traits related to a gene encoded on one of the autosomes (i.e., the human chromosomes 1-22) in which a trait manifests in individuals with two pathogenic alleles, either homozygotes (two copies of the same mutant allele) or compound heterozygotes (whereby each copy of a gene has a distinct mutant allele). Evidence: PCS. (PMID:36190515)
- Cyanosis (HP:0000961): Bluish discoloration of the skin and mucosa due to poor circulation or inadequate oxygenation of arterial or capillary blood. Evidence: PCS. Frequency: 1/1. (PMID:36190515)
- Focal-onset seizure (HP:0007359): A focal-onset seizure is a type of seizure originating within networks limited to one hemisphere. They may be discretely localized or more widely distributed, and may originate in subcortical structures. Evidence: PCS. Frequency: 1/1. (PMID:36190515)
- Apnea (HP:0002104): Lack of breathing with no movement of the respiratory muscles and no exchange of air in the lungs. This term refers to a disposition to have recurrent episodes of apnea rather than to a single event. Evidence: PCS. Frequency: 2/2. (PMID:36190515)
- Respiratory failure requiring assisted ventilation (HP:0004887): A state of respiratory distress that requires a life saving intervention in the form of gaining airway access and instituting positive pressure ventilation. Evidence: PCS. Frequency: 2/2. (PMID:36190515)
- Coma (HP:0001259): The complete absence of wakefulness and consciousness, which is evident through a lack of response to any form of external stimuli. Evidence: PCS. Frequency: 2/2. (PMID:36190515)
- Myoclonus (HP:0001336): Very brief, involuntary random muscular contractions occurring at rest, in response to sensory stimuli, or accompanying voluntary movements. Evidence: PCS. Frequency: 1/1. (PMID:36190515)
- Abnormal diffusion weighted cerebral MRI morphology (HP:0032615): A diffusion abnormality observed in diffusion-weighted magnetic resonance imaging (MRI) of the brain. Molecular diffusion refers to the notion that any type of molecule in a fluid (eg, water) is randomly displaced as the molecule is agitated by thermal energy. Restricted diffusion of water appears bright on diffusion-weighted images. Evidence: PCS. Frequency: 3/3. (PMID:36190515)
- Hypertonia (HP:0001276): A condition in which there is increased muscle tone so that arms or legs, for example, are stiff and difficult to move. Evidence: PCS. Frequency: 1/1. (PMID:33890291)
- Hypsarrhythmia (HP:0002521): Hypsarrhythmia is abnormal interictal high amplitude waves and a background of irregular spikes. There is continuous (during wakefulness), high-amplitude (>200 Hz), generalized polymorphic slowing with no organized background and multifocal spikes demonstrated by electroencephalography (EEG). Evidence: PCS. Frequency: 1/1. (PMID:36190515)
- Congenital onset (HP:0003577): A phenotypic abnormality that is present at birth. Evidence: PCS. Frequency: 2/6. (PMID:36190515)
- Anteverted nares (HP:0000463): Anteriorly-facing nostrils viewed with the head in the Frankfurt horizontal and the eyes of the observer level with the eyes of the subject. This gives the appearance of an upturned nose (upturned nasal tip). Evidence: PCS. Frequency: 1/1. (PMID:33890291)
- Hallucinations (HP:0000738): Perceptions in a conscious and awake state that, in the absence of external stimuli, have qualities of real perception. These perceptions are vivid, substantial, and located in external objective space. Evidence: PCS. Frequency: 1/1. (PMID:36190515)
- Irritability (HP:0000737): An emotional state characterized by negative feelings of heightened frustration, annoyance, or feeling upset, often triggered by internal factors (e.g., fatigue, hunger, unfulfilled desires) or external factors (e.g., social or environmental challenges). Irritability may be unpredictable, and is accompanied by a lowered threshold for emotional reactivity and observable features (speech, facial expressions, or psychomotor activity). Evidence: PCS. Frequency: 1/1. (PMID:36190515)
- Hypoglycemia (HP:0001943): A decreased concentration of glucose in the blood. Evidence: PCS. Frequency: 1/1. (PMID:36190515)
- Gingival overgrowth (HP:0000212): Hyperplasia of the gingiva (that is, a thickening of the soft tissue overlying the alveolar ridge. The degree of thickening ranges from involvement of the interdental papillae alone to gingival overgrowth covering the entire tooth crown. Evidence: PCS. Frequency: 1/1. (PMID:33890291)
- Metabolic acidosis (HP:0001942): Metabolic acidosis (MA) is characterized by a fall in blood pH due to a reduction of serum bicarbonate concentration. This can occur as a result of either the accumulation of acids (high anion gap MA) or the loss of bicarbonate from the gastrointestinal tract or the kidney (hyperchloremic MA). By definition, MA is not due to a respirary cause. Evidence: PCS. Frequency: 1/2. (PMID:33890291)
- Hyperreflexia (HP:0001347): Hyperreflexia is the presence of hyperactive stretch reflexes of the muscles. Evidence: PCS. Frequency: 1/1. (PMID:36190515)
- Axial hypotonia (HP:0008936): Muscular hypotonia (abnormally low muscle tone) affecting the musculature of the trunk. Evidence: PCS. Frequency: 1/1. (PMID:36190515)
- Open mouth (HP:0000194): A facial appearance characterized by a permanently or nearly permanently opened mouth. Evidence: PCS. Frequency: 1/1. (PMID:33890291)
- Areflexia (HP:0001284): Absence of neurologic reflexes such as the knee-jerk reaction. Evidence: PCS. Frequency: 1/1. (PMID:36190515)
- Secondary microcephaly (HP:0005484): Head circumference which falls below 2 standard deviations below the mean for age and gender because of insufficient head growth after birth. Evidence: PCS. Frequency: 1/1. (PMID:33890291)
- EEG with burst suppression (HP:0010851): The burst suppression pattern in electroencephalography refers to a characteristic periodic pattern of low voltage (<10 microvolts) suppressed background and a relatively shorter pattern of higher amplitude slow, sharp, and spiking complexes. Evidence: PCS. Frequency: 2/2. (PMID:36190515)
- Impulsivity (HP:0100710): Acting on the spur of the moment or on a momentary basis without consideration of outcomes; having difficulty establishing or following plans; experiencing a sense of urgency and engaging in behavior that is uninhibited, cannot be inhibited, and is uncontrolled. The possibility of repression is inconceivable. Evidence: PCS. Frequency: 1/1. (PMID:36190515)
- Elevated brain glycine level by MRS (HP:0034893): An increase in the level of glycine in the brain identified by magnetic resonance spectroscopy (MRS). Evidence: PCS. Frequency: 2/2. (PMID:33890291)
- Dolichocephaly (HP:0000268): An abnormality of skull shape characterized by a increased anterior-posterior diameter, i.e., an increased antero-posterior dimension of the skull. Cephalic index less than 76%. Alternatively, an apparently increased antero-posterior length of the head compared to width. Often due to premature closure of the sagittal suture. Evidence: PCS. Frequency: 1/1. (PMID:33890291)
- Thrombocytopenia (HP:0001873): A reduction in the number of circulating thrombocytes. Evidence: PCS. Frequency: 1/1. (PMID:36190515)